Phenotypes associated with the disease TONGUE CURLING, FOLDING, OR ROLLINGCLOVERLEAF TONGUE, INCLUDED (OMIM:189300):
- Abnormality of the mouth (HP:0000153): An abnormality of the mouth. Evidence: IEA. (OMIM:189300)
- Autosomal dominant inheritance (HP:0000006): A mode of inheritance that is observed for traits related to a gene encoded on one of the autosomes (i.e., the human chromosomes 1-22) in which a trait manifests in heterozygotes. In the context of medical genetics, an autosomal dominant disorder is caused when a single copy of the mutant allele is present. Males and females are affected equally, and can both transmit the disorder with a risk of 50% for each child of inheriting the mutant allele. Evidence: TAS. (OMIM:189300)